Phenotypes associated with the disease motion sickness (OMIM:158280):
- Abnormality of the nervous system (HP:0000707): An abnormality of the nervous system. Evidence: IEA. (OMIM:158280)